Phenotypes associated with the disease Autosomal recessive spastic paraplegia type 54 (ORPHA:320380):
- Intellectual disability (HP:0001249): The term intellectual disability or intellectual developmental disorder is used to describe significantly sub-average intellectual and adaptive functioning based on clinical assessment and as measured by individually administered, appropriately normed, standardized and validated tests of intellectual functioning and adaptive behavior, with onset during the developmental period from infancy through adolescence. Evidence: TAS. Frequency: Very frequent (HP:0040281). (ORPHA:320380)
- Spastic paraplegia (HP:0001258): Complete loss of the ability to move the lower limbs accompanied by spasticity of the lower limbs. Evidence: TAS. Frequency: Very frequent (HP:0040281). (ORPHA:320380)
- Global developmental delay (HP:0001263): A delay in the achievement of motor or mental milestones in the domains of development of a child, including motor skills, speech and language, cognitive skills, and social and emotional skills. This term should only be used to describe children younger than five years of age. Evidence: TAS. Frequency: Very frequent (HP:0040281). (ORPHA:320380)
- Strabismus (HP:0000486): A misalignment of the eyes so that the visual axes deviate from bifoveal fixation. The classification of strabismus may be based on a number of features including the relative position of the eyes, whether the deviation is latent or manifest, intermittent or constant, concomitant or otherwise and according to the age of onset and the relevance of any associated refractive error. Evidence: TAS. Frequency: Frequent (HP:0040282). (ORPHA:320380)
- Dysarthria (HP:0001260): Dysarthric speech is a general description referring to a neurological speech disorder characterized by poor articulation. Depending on the involved neurological structures, dysarthria may be further classified as spastic, flaccid, ataxic, hyperkinetic and hypokinetic, or mixed. Evidence: TAS. Frequency: Frequent (HP:0040282). (ORPHA:320380)
- Gait disturbance (HP:0001288): The term gait disturbance can refer to any disruption of the ability to walk. Evidence: TAS. Frequency: Frequent (HP:0040282). (ORPHA:320380)
- Dysphagia (HP:0002015): Difficulty in swallowing. Evidence: TAS. Frequency: Frequent (HP:0040282). (ORPHA:320380)
- Spastic gait (HP:0002064): Spasticity is manifested by increased stretch reflex which is intensified with movement velocity. This results in excessive and inappropriate muscle activation which can contribute to muscle hypertonia. Spastic gait is characterized by manifestations such as muscle hypertonia, stiff knee, and circumduction of the leg. Evidence: TAS. Frequency: Frequent (HP:0040282). (ORPHA:320380)
- Hypoplasia of the corpus callosum (HP:0002079): Underdevelopment of the corpus callosum. Evidence: TAS. Frequency: Frequent (HP:0040282). (ORPHA:320380)
- Optic disc hypoplasia (HP:0007766): Underdevelopment of the optic disc, that is of the optic nerve head, where ganglion cell axons exit the eye to form the optic nerve. Evidence: TAS. Frequency: Frequent (HP:0040282). (ORPHA:320380)
- Foot joint contracture (HP:0008366): Contractures of one or more joints of the feet meaning chronic loss of joint motion due to structural changes in non-bony tissue. Evidence: TAS. Frequency: Frequent (HP:0040282). (ORPHA:320380)
- Periventricular white matter hyperintensities (HP:0030891): Areas of brighter than expected signal on magnetic resonance imaging emanating from the cerebral white matter that surrounds the cerebral ventricles. Evidence: TAS. Frequency: Frequent (HP:0040282). (ORPHA:320380)
- High palate (HP:0000218): Height of the palate more than 2 SD above the mean (objective) or palatal height at the level of the first permanent molar more than twice the height of the teeth (subjective). Evidence: TAS. Frequency: Occasional (HP:0040283). (ORPHA:320380)
- Short stature (HP:0004322): A height below that which is expected according to age and gender norms. Although there is no universally accepted definition of short stature, many refer to "short stature" as height more than 2 standard deviations below the mean for age and gender (or below the 3rd percentile for age and gender dependent norms). Evidence: TAS. Frequency: Occasional (HP:0040283). (ORPHA:320380)
- Periventricular leukomalacia (HP:0006970): Periventricular leukomalacia is characterized by diffuse injury of deep cerebral white matter, accompanied in its most severe form by focal necrosis. The neuropathologic hallmarks of PVL are microglial activation and focal and diffuse periventricular depletion of premyelinating oligodendroglia. Evidence: TAS. Frequency: Occasional (HP:0040283). (ORPHA:320380)
- Tip-toe gait (HP:0030051): An abnormal gait pattern characterized by the failure of the heel to contact the floor at the onset of stance during gait. Evidence: TAS. Frequency: Occasional (HP:0040283). (ORPHA:320380)